Phenotypes associated with the disease progesterone resistance (OMIM:264080):
- Abnormality of metabolism/homeostasis (HP:0001939). Evidence: IEA. (OMIM:264080)
- Female infertility (HP:0008222). Evidence: IEA. (OMIM:264080)
- Autosomal recessive inheritance (HP:0000007): A mode of inheritance that is observed for traits related to a gene encoded on one of the autosomes (i.e., the human chromosomes 1-22) in which a trait manifests in individuals with two pathogenic alleles, either homozygotes (two copies of the same mutant allele) or compound heterozygotes (whereby each copy of a gene has a distinct mutant allele). Evidence: IEA. (OMIM:264080)